Phenotypes associated with the disease Angelman syndrome due to maternal 15q11q13 deletion (ORPHA:98794):
- EEG abnormality (HP:0002353): Abnormality observed by electroencephalogram (EEG), which is used to record of the brain's spontaneous electrical activity from multiple electrodes placed on the scalp. Evidence: TAS. Frequency: Very frequent (HP:0040281). (ORPHA:98794)
- Cessation of head growth (HP:0004485): Stagnation of head growth seen as flattening of the head circumference curve. Evidence: TAS. Frequency: Very frequent (HP:0040281). (ORPHA:98794)
- Secondary microcephaly (HP:0005484): Head circumference which falls below 2 standard deviations below the mean for age and gender because of insufficient head growth after birth. Evidence: TAS. Frequency: Very frequent (HP:0040281). (ORPHA:98794)
- EEG with abnormally slow frequencies (HP:0011203): EEG with abnormally slow frequencies. Evidence: TAS. Frequency: Very frequent (HP:0040281). (ORPHA:98794)
- Neurodevelopmental delay (HP:0012758): Neurodevelopmental delay (NDD) refers to delays in the maturation of the brain and central nervous system; infants and young children with NDD may experience delays in the development of one or more skills including gross motor abilities, fine-motor coordination, language abilities and ability to solve increasingly complex problems. Evidence: TAS. Frequency: Very frequent (HP:0040281). (ORPHA:98794)
- Wide mouth (HP:0000154): Distance between the oral commissures more than 2 SD above the mean. Alternatively, an apparently increased width of the oral aperture (subjective). Evidence: TAS. Frequency: Frequent (HP:0040282). (ORPHA:98794)
- Strabismus (HP:0000486): A misalignment of the eyes so that the visual axes deviate from bifoveal fixation. The classification of strabismus may be based on a number of features including the relative position of the eyes, whether the deviation is latent or manifest, intermittent or constant, concomitant or otherwise and according to the age of onset and the relevance of any associated refractive error. Evidence: TAS. Frequency: Frequent (HP:0040282). (ORPHA:98794)
- Widely spaced teeth (HP:0000687): Increased spaces (diastemata) between most of the teeth in the same dental arch. Evidence: TAS. Frequency: Frequent (HP:0040282). (ORPHA:98794)
- Autistic behavior (HP:0000729): Persistent deficits in social interaction and communication and interaction as well as a markedly restricted repertoire of activity and interest as well as repetitive patterns of behavior. Evidence: TAS. Frequency: Frequent (HP:0040282). (ORPHA:98794)
- Short attention span (HP:0000736): Reduced attention span characterized by distractibility and impulsivity. Evidence: TAS. Frequency: Frequent (HP:0040282). (ORPHA:98794)
- Inappropriate laughter (HP:0000748): Laughing that may be excessive and/or inappropriate in context (e.g., laughing at a funeral while others are crying). Evidence: TAS. Frequency: Frequent (HP:0040282). (ORPHA:98794)
- Hyperactivity (HP:0000752): Hyperactivity is a condition characterized by constant and unusually high levels of activity, even in situations where it is deemed inappropriate. Evidence: TAS. Frequency: Frequent (HP:0040282). (ORPHA:98794)
- Hypopigmentation of the skin (HP:0001010): A reduction of skin color related to a decrease in melanin production and deposition. Evidence: TAS. Frequency: Frequent (HP:0040282). (ORPHA:98794)
- Obesity (HP:0001513): Accumulation of substantial excess body fat. Evidence: TAS. Frequency: Frequent (HP:0040282). (ORPHA:98794)
- Constipation (HP:0002019): Infrequent or difficult evacuation of feces. Evidence: TAS. Frequency: Frequent (HP:0040282). (ORPHA:98794)
- Poor suck (HP:0002033): An inadequate sucking reflex, resulting in the difficult of newborns to be breast-fed. Evidence: TAS. Frequency: Frequent (HP:0040282). (ORPHA:98794)
- Hypoplasia of the corpus callosum (HP:0002079): Underdevelopment of the corpus callosum. Evidence: TAS. Frequency: Frequent (HP:0040282). (ORPHA:98794)
- Abnormal speech pattern (HP:0002167): An abnormality in the sound (volume) or cadence (rate) of speech. Evidence: TAS. Frequency: Frequent (HP:0040282). (ORPHA:98794)
- Drooling (HP:0002307): Habitual flow of saliva out of the mouth. Evidence: TAS. Frequency: Frequent (HP:0040282). (ORPHA:98794)
- Lower limb hyperreflexia (HP:0002395): Increased intensity of the a reflex in the leg. Evidence: TAS. Frequency: Frequent (HP:0040282). (ORPHA:98794)
- Scoliosis (HP:0002650): The presence of an abnormal lateral curvature of the spine. Evidence: TAS. Frequency: Frequent (HP:0040282). (ORPHA:98794)
- Functional motor deficit (HP:0004302). Evidence: TAS. Frequency: Frequent (HP:0040282). (ORPHA:98794)
- Flat occiput (HP:0005469): Reduced convexity of the occiput (posterior part of skull). Evidence: TAS. Frequency: Frequent (HP:0040282). (ORPHA:98794)
- Hypopigmentation of hair (HP:0005599). Evidence: TAS. Frequency: Frequent (HP:0040282). (ORPHA:98794)
- Iris hypopigmentation (HP:0007730): An abnormal reduction in the amount of pigmentation of the iris. Evidence: TAS. Frequency: Frequent (HP:0040282). (ORPHA:98794)
- Floppy infant (HP:0008947): Floppiness/hypotonia is defined as reduced resistance to passive movement of joints. Physical examination of floppy/hypotonic infants shows head lag, lack of shoulder and elbow muscle contraction on traction response, inability to tighten the shoulder girdle muscles (or slipping through) when held under the axillae, scarf sign (when the arm is pulled to the opposite side, the arm wraps around the neck with the elbow crossing midline), hyperdorsiflexion of the feet, easy apposition of the thumb against the forearm, feet touching the cheek with ease and without discomfort, frog leg position, and inverted U sign on ventral suspension (head, arms, and legs hanging down without elbow or knee flexion and the trunk rounded in a dome shape). Evidence: TAS. Frequency: Frequent (HP:0040282). (ORPHA:98794)
- Protruding tongue (HP:0010808): Tongue extending beyond the alveolar ridges or teeth at rest. Evidence: TAS. Frequency: Frequent (HP:0040282). (ORPHA:98794)
- Severe intellectual disability (HP:0010864): Severe intellectual disability (ID) is defined as a type of ID characterized by severely sub-average adaptive functioning and intellectual functioning, with an intelligence quotient (IQ) the range of 20-34. Evidence: TAS. Frequency: Frequent (HP:0040282). (ORPHA:98794)
- Feeding difficulties (HP:0011968): Impaired ability to eat related to problems gathering food and getting ready to suck, chew, or swallow it. Evidence: TAS. Frequency: Frequent (HP:0040282). (ORPHA:98794)
- Delayed myelination (HP:0012448): Delayed myelination. Evidence: TAS. Frequency: Frequent (HP:0040282). (ORPHA:98794)
- Happy demeanor (HP:0040082): A conspicuously happy disposition, characterized by frequent smiling and laughing, which may be contextually inappropriate or unrelated to the situation. Evidence: TAS. Frequency: Frequent (HP:0040282). (ORPHA:98794)
- Tongue thrusting (HP:0100703): Pressing forward of the tongue in the mouth, a retained motoric habit from infantile swallowing patterns. Evidence: TAS. Frequency: Frequent (HP:0040282). (ORPHA:98794)
- Abnormal eating behavior (HP:0100738): Abnormal eating habits involve excessive or insufficient consumption of food, or any other abnormal pattern of food consumption. Evidence: TAS. Frequency: Frequent (HP:0040282). (ORPHA:98794)
- Mandibular prognathia (HP:0000303): Abnormal prominence of the chin related to increased length of the mandible. Evidence: TAS. Frequency: Occasional (HP:0040283). (ORPHA:98794)
- Ataxia (HP:0001251): Ataxia refers to impaired coordination of voluntary muscle movement. Cerebellar ataxia refers to ataxia due to dysfunction of the cerebellum. This causes a variety of elementary neurological deficits including asynergy (lack of coordination between muscles, limbs and joints), dysmetria (lack of ability to judge distances that can lead to under- or overshoot in grasping movements), and dysdiadochokinesia (inability to perform rapid movements requiring antagonizing muscle groups to be switched on and off repeatedly). Evidence: TAS. Frequency: Occasional (HP:0040283). (ORPHA:98794)
- Myoclonus (HP:0001336): Very brief, involuntary random muscular contractions occurring at rest, in response to sensory stimuli, or accompanying voluntary movements. Evidence: TAS. Frequency: Occasional (HP:0040283). (ORPHA:98794)
- Tremor (HP:0001337): An unintentional, oscillating to-and-fro muscle movement about a joint axis. Evidence: TAS. Frequency: Occasional (HP:0040283). (ORPHA:98794)
- Absent speech (HP:0001344): Complete lack of development of speech and language abilities. Evidence: TAS. Frequency: Occasional (HP:0040283). (ORPHA:98794)
- Dysphagia (HP:0002015): Difficulty in swallowing. Evidence: TAS. Frequency: Occasional (HP:0040283). (ORPHA:98794)
- Heat intolerance (HP:0002046): The inability to maintain a comfortable body temperature in warm or hot weather. Evidence: TAS. Frequency: Occasional (HP:0040283). (ORPHA:98794)
- Broad-based gait (HP:0002136): An abnormal gait pattern in which persons stand and walk with their feet spaced widely apart. This is often a component of cerebellar ataxia. Evidence: TAS. Frequency: Occasional (HP:0040283). (ORPHA:98794)
- Gait imbalance (HP:0002141). Evidence: TAS. Frequency: Occasional (HP:0040283). (ORPHA:98794)
- Poor speech (HP:0002465). Evidence: TAS. Frequency: Occasional (HP:0040283). (ORPHA:98794)
- Limitation of movement at ankles (HP:0010505): An abnormal limitation of the mobility of the ankle joint. Evidence: TAS. Frequency: Occasional (HP:0040283). (ORPHA:98794)
- Shortened sleep phase (HP:0033063): A tendency to sleep fewer hours than usual while feeling well-rested. Evidence: TAS. Frequency: Occasional (HP:0040283). (ORPHA:98794)
- Mild microcephaly (HP:0040196): Decreased occipito-frontal (head) circumference (OFC). For the microcephaly OFC must be between -3 SD and -2 SD compared to appropriate, age matched, normal standards (i.e. -3 SD <= OFC < -2 SD). Evidence: TAS. Frequency: Occasional (HP:0040283). (ORPHA:98794)
- Abnormality of movement (HP:0100022): An abnormality of movement with a neurological basis characterized by changes in coordination and speed of voluntary movements. Evidence: TAS. Frequency: Occasional (HP:0040283). (ORPHA:98794)
- Recurrent hand flapping (HP:0100023): A type of repetitive behavior in which the affected individual repeatedly waves the hands and/or arms rhythmically. Evidence: TAS. Frequency: Occasional (HP:0040283). (ORPHA:98794)
- Seizure (HP:0001250): A seizure is an intermittent abnormality of nervous system physiology characterized by a transient occurrence of signs and/or symptoms due to abnormal excessive or synchronous neuronal activity in the brain. Evidence: TAS. Frequency: Very frequent (HP:0040281). (ORPHA:98794)
- Global developmental delay (HP:0001263): A delay in the achievement of motor or mental milestones in the domains of development of a child, including motor skills, speech and language, cognitive skills, and social and emotional skills. This term should only be used to describe children younger than five years of age. Evidence: TAS. Frequency: Very frequent (HP:0040281). (ORPHA:98794)